Phenotypes associated with the disease sella turcica, bridged (OMIM:182200):
- Autosomal dominant inheritance (HP:0000006): A mode of inheritance that is observed for traits related to a gene encoded on one of the autosomes (i.e., the human chromosomes 1-22) in which a trait manifests in heterozygotes. In the context of medical genetics, an autosomal dominant disorder is caused when a single copy of the mutant allele is present. Males and females are affected equally, and can both transmit the disorder with a risk of 50% for each child of inheriting the mutant allele. Evidence: IEA. (OMIM:182200)
- Bridged sella turcica (HP:0005449). Evidence: IEA. (OMIM:182200)